Phenotypes associated with the disease acetylation, slow (OMIM:243400):
- Abnormality of metabolism/homeostasis (HP:0001939). Evidence: IEA. (OMIM:243400)
- Autosomal recessive inheritance (HP:0000007): A mode of inheritance that is observed for traits related to a gene encoded on one of the autosomes (i.e., the human chromosomes 1-22) in which a trait manifests in individuals with two pathogenic alleles, either homozygotes (two copies of the same mutant allele) or compound heterozygotes (whereby each copy of a gene has a distinct mutant allele). Evidence: IEA. (OMIM:243400)